- Abnormal hair morphology (HP:0001595): An abnormality of the hair. Evidence: IEA. (OMIM:180600)
- Autosomal dominant inheritance (HP:0000006): A mode of inheritance that is observed for traits related to a gene encoded on one of the autosomes (i.e., the human chromosomes 1-22) in which a trait manifests in heterozygotes. In the context of medical genetics, an autosomal dominant disorder is caused when a single copy of the mutant allele is present. Males and females are affected equally, and can both transmit the disorder with a risk of 50% for each child of inheriting the mutant allele. Evidence: IEA. (OMIM:180600)
These phenotypes are associated with the disease ringed hair disease (OMIM:180600).